- Tremor (HP:0001337): An unintentional, oscillating to-and-fro muscle movement about a joint axis. Evidence: TAS. Frequency: Very frequent (HP:0040281). (ORPHA:238606)
- Abnormality of extrapyramidal motor function (HP:0002071): A neurological condition related to lesions of the basal ganglia leading to typical abnormalities including akinesia (inability to initiate changes in activity and perform volitional movements rapidly and easily), muscular rigidity (continuous contraction of muscles with constant resistance to passive movement), chorea (widespread arrhythmic movements of a forcible, rapid, jerky, and restless nature), athetosis (inability to sustain the muscles of the fingers, toes, or other group of muscles in a fixed position), and akathisia (inability to remain motionless). Evidence: TAS. Frequency: Occasional (HP:0040283). (ORPHA:238606)
- Abnormality of the musculature (HP:0003011): Abnormality originating in one or more muscles, i.e., of the set of muscles of body. Evidence: TAS. Frequency: Very frequent (HP:0040281). (ORPHA:238606)
- Myalgia (HP:0003326): Pain in muscle. Evidence: TAS. Frequency: Frequent (HP:0040282). (ORPHA:238606)
- Muscle spasm (HP:0003394): Sudden and involuntary contractions of one or more muscles. Evidence: TAS. Frequency: Very frequent (HP:0040281). (ORPHA:238606)
- EMG abnormality (HP:0003457): Abnormal results of investigations using electromyography (EMG). Evidence: TAS. Frequency: Very frequent (HP:0040281). (ORPHA:238606)
- Abnormality of movement (HP:0100022): An abnormality of movement with a neurological basis characterized by changes in coordination and speed of voluntary movements. Evidence: TAS. Frequency: Very frequent (HP:0040281). (ORPHA:238606)
These phenotypes are associated with the disease Primary orthostatic tremor (ORPHA:238606).